- Corneal crystals (HP:0000531). Evidence: TAS. Frequency: Very frequent (HP:0040281). (ORPHA:98963)
- Granular corneal dystrophy (HP:0007802): The presence of central, fine, whitish granular lesions in the stroma of the cornea. This type of corneal dystrophy is usually asymptomatic and begins in childhood and shows a slow progression. Later in the course, the corneal epithelium and Bowman's layer may be affected. Histologically, the cornea shows a uniform deposition of hyaline material. Evidence: TAS. Frequency: Very frequent (HP:0040281). (ORPHA:98963)
- Central opacification of the cornea (HP:0011493): Reduced transparency of the central portion of the corneal stroma. Evidence: TAS. Frequency: Very frequent (HP:0040281). (ORPHA:98963)
- Visual impairment (HP:0000505): Visual impairment (or vision impairment) is vision loss (of a person) to such a degree as to qualify as an additional support need through a significant limitation of visual capability resulting from either disease, trauma, or congenital or degenerative conditions that cannot be corrected by conventional means, such as refractive correction, medication, or surgery. Evidence: TAS. Frequency: Frequent (HP:0040282). (ORPHA:98963)
- Reduced visual acuity (HP:0007663). Evidence: TAS. Frequency: Frequent (HP:0040282). (ORPHA:98963)
- Opacification of the corneal stroma (HP:0007759): Reduced transparency of the stroma of cornea. Evidence: TAS. Frequency: Frequent (HP:0040282). (ORPHA:98963)
- Subepithelial corneal opacities (HP:0008039). Evidence: TAS. Frequency: Frequent (HP:0040282). (ORPHA:98963)
- Recurrent corneal erosions (HP:0000495): The presence of recurrent corneal epithelial erosions. Although most corneal epithelial defects heal quickly, some may show recurrent ulcerations. Evidence: TAS. Frequency: Occasional (HP:0040283). (ORPHA:98963)
- Blurred vision (HP:0000622): Lack of sharpness of vision resulting in the inability to see fine detail. Evidence: TAS. Frequency: Occasional (HP:0040283). (ORPHA:98963)
These phenotypes are associated with the disease Granular corneal dystrophy type II (ORPHA:98963).